- Juvenile onset (HP:0003621): Onset of signs or symptoms of disease between the age of 5 and 15 years. Evidence: PCS. (PMID:23936043)
- Abnormal vestibular function (HP:0001751): An abnormality of the functioning of the vestibular apparatus. Evidence: PCS. Frequency: 0/11. (PMID:23936043)
- Sensorineural hearing impairment (HP:0000407): A type of hearing impairment in one or both ears related to an abnormal functionality of the cochlear nerve. Evidence: PCS. Frequency: 11/11. (PMID:23936043)
- Young adult onset (HP:0011462): Onset of disease at the age of between 16 and 40 years. Evidence: PCS. (PMID:23936043)
- Autosomal dominant inheritance (HP:0000006): A mode of inheritance that is observed for traits related to a gene encoded on one of the autosomes (i.e., the human chromosomes 1-22) in which a trait manifests in heterozygotes. In the context of medical genetics, an autosomal dominant disorder is caused when a single copy of the mutant allele is present. Males and females are affected equally, and can both transmit the disorder with a risk of 50% for each child of inheriting the mutant allele. Evidence: PCS. (PMID:23936043)
These phenotypes are associated with the disease autosomal dominant nonsyndromic hearing loss 56 (OMIM:615629).